Phenotypes associated with the disease intellectual developmental disorder with seizures and dysmorphic facies (OMIM:621457):
- Moderate intellectual disability (HP:0002342): Moderate intellectual disability (ID) is defined as a type of ID characterized by moderately sub-average adaptive functioning and intellectual functioning, with an intelligence quotient (IQ) the range of 35-49. Evidence: PCS. Frequency: 1/1. (PMID:41125872)
- Hypoplastic nasal tip (HP:0005278). Evidence: PCS. Frequency: 1/1. (PMID:41125872)
- Hypotonia (HP:0001252): Hypotonia is an abnormally low muscle tone (the amount of tension or resistance to movement in a muscle). Even when relaxed, muscles have a continuous and passive partial contraction which provides some resistance to passive stretching. Hypotonia thus manifests as diminished resistance to passive stretching. Hypotonia is not the same as muscle weakness, although the two conditions can co-exist. Evidence: PCS. Frequency: 1/1. (PMID:41125872)
- Motor delay (HP:0001270): A type of Developmental delay characterized by a delay in acquiring motor skills. Evidence: PCS. Frequency: 0/1. (PMID:41125872)
- Smooth philtrum (HP:0000319): Flat skin surface, with no ridge formation in the central region of the upper lip between the nasal base and upper vermilion border. Evidence: PCS. Frequency: 1/1. (PMID:41125872)
- Lumbar hyperlordosis (HP:0002938): An abnormal accentuation of the inward curvature of the spine in the lumbar region. Evidence: PCS. Frequency: 1/1. (PMID:41125872)
- Hypertelorism (HP:0000316): Interpupillary distance more than 2 SD above the mean (alternatively, the appearance of an increased interpupillary distance or widely spaced eyes). Evidence: PCS. Frequency: 1/1. (PMID:41125872)
- Broad forehead (HP:0000337): Width of the forehead or distance between the frontotemporales is more than two standard deviations above the mean (objective); or apparently increased distance between the two sides of the forehead. Evidence: PCS. Frequency: 1/1. (PMID:41125872)
- Genu valgum (HP:0002857): The legs angle inward, such that the knees are close together and the ankles far apart. Evidence: PCS. Frequency: 1/1. (PMID:41125872)
- Hyperactivity (HP:0000752): Hyperactivity is a condition characterized by constant and unusually high levels of activity, even in situations where it is deemed inappropriate. Evidence: PCS. Frequency: 1/1. (PMID:41125872)
- Tall stature (HP:0000098): A height above that which is expected according to age and gender norms. Evidence: PCS. Frequency: 1/1. (PMID:41125872)
- Spastic diplegia (HP:0001264): Spasticity (neuromuscular hypertonia) primarily in the muscles of the legs, hips, and pelvis. Evidence: PCS. Frequency: 1/1. (PMID:41125872)
- Delayed speech and language development (HP:0000750): A degree of language development that is significantly below the norm for a child of a specified age. Evidence: PCS. Frequency: 1/1. (PMID:41125872)
- Underdeveloped nasal alae (HP:0000430): Thinned, deficient, or excessively arched ala nasi. Evidence: PCS. Frequency: 1/1. (PMID:41125872)
- Everted lower lip vermilion (HP:0000232): An abnormal configuration of the lower lip such that it is turned outward i.e., everted, with the Inner aspect of the lower lip vermilion (normally opposing the teeth) being visible in a frontal view. Evidence: PCS. Frequency: 1/1. (PMID:41125872)
- Gait disturbance (HP:0001288): The term gait disturbance can refer to any disruption of the ability to walk. Evidence: PCS. Frequency: 1/1. (PMID:41125872)
- Deeply set eye (HP:0000490): An eye that is more deeply recessed into the plane of the face than is typical. Evidence: PCS. Frequency: 1/1. (PMID:41125872)
- Dysarthria (HP:0001260): Dysarthric speech is a general description referring to a neurological speech disorder characterized by poor articulation. Depending on the involved neurological structures, dysarthria may be further classified as spastic, flaccid, ataxic, hyperkinetic and hypokinetic, or mixed. Evidence: PCS. Frequency: 1/1. (PMID:41125872)
- Bilateral tonic-clonic seizure with generalized onset (HP:0025190): A bilateral tonic-clonic seizure with generalized onset is a type of bilateral tonic-clonic seizure characterized by generalized onset; these seizures rapidly engage networks in both hemispheres at the start of the seizure. Evidence: PCS. Frequency: 1/1. (PMID:41125872)
- Depressed nasal bridge (HP:0005280): Posterior positioning of the nasal root in relation to the overall facial profile for age. Evidence: PCS. Frequency: 1/1. (PMID:41125872)
- EEG with central sharp waves (HP:0011293): EEG with sharp waves in the central region, i.e., sharp transient waves of a duration between 80 and 200 msec. Evidence: PCS. Frequency: 1/1. (PMID:41125872)
- Simple febrile seizure (HP:0011171): A short generalized seizure, of a duration of <15 min, not recurring within 24 h, occurring during a febrile episode not caused by an acute disease of the nervous system intracranial infection or severe metabolic disturbance. Evidence: PCS. Frequency: 1/1. (PMID:41125872)
- Primary microcephaly (HP:0011451): Head circumference below 2 standard deviations below the mean for age and gender at birth. Evidence: PCS. Frequency: 0/1. (PMID:41125872)
- High forehead (HP:0000348): An abnormally increased height of the forehead. Evidence: PCS. Frequency: 1/1. (PMID:41125872)
- Truncal obesity (HP:0001956): Obesity located preferentially in the trunk of the body as opposed to the extremities. Evidence: PCS. Frequency: 1/1. (PMID:41125872)
- Broad philtrum (HP:0000289): Distance between the philtral ridges, measured just above the vermilion border, more than 2 standard deviations above the mean, or alternatively, an apparently increased distance between the ridges of the philtrum. Evidence: PCS. Frequency: 1/1. (PMID:41125872)
- Autosomal dominant inheritance (HP:0000006): A mode of inheritance that is observed for traits related to a gene encoded on one of the autosomes (i.e., the human chromosomes 1-22) in which a trait manifests in heterozygotes. In the context of medical genetics, an autosomal dominant disorder is caused when a single copy of the mutant allele is present. Males and females are affected equally, and can both transmit the disorder with a risk of 50% for each child of inheriting the mutant allele. Evidence: PCS. (PMID:41125872)